- Seizure (HP:0001250): A seizure is an intermittent abnormality of nervous system physiology characterized by a transient occurrence of signs and/or symptoms due to abnormal excessive or synchronous neuronal activity in the brain. Evidence: TAS. Frequency: Frequent (HP:0040282). (ORPHA:85338)
- Ataxia (HP:0001251): Ataxia refers to impaired coordination of voluntary muscle movement. Cerebellar ataxia refers to ataxia due to dysfunction of the cerebellum. This causes a variety of elementary neurological deficits including asynergy (lack of coordination between muscles, limbs and joints), dysmetria (lack of ability to judge distances that can lead to under- or overshoot in grasping movements), and dysdiadochokinesia (inability to perform rapid movements requiring antagonizing muscle groups to be switched on and off repeatedly). Evidence: TAS. Frequency: Very frequent (HP:0040281). (ORPHA:85338)
- Mild intellectual disability (HP:0001256): Mild intellectual disability (ID) is defined as a type of ID characterized by mildly sub-average adaptive functioning and intellectual functioning, with an intelligence quotient (IQ) the range of 50-69. Evidence: TAS. Frequency: Very frequent (HP:0040281). (ORPHA:85338)
- Talipes equinovarus (HP:0001762): Talipes equinovarus (also called clubfoot) typically has four main components: inversion and adduction of the forefoot; inversion of the heel and hindfoot; equinus (limitation of extension) of the ankle and subtalar joint; and internal rotation of the leg. Evidence: TAS. Frequency: Frequent (HP:0040282). (ORPHA:85338)
- Apraxia (HP:0002186): A defect in the understanding of complex motor commands and in the execution of certain learned movements, i.e., deficits in the cognitive components of learned movements. Evidence: TAS. Frequency: Very frequent (HP:0040281). (ORPHA:85338)
These phenotypes are associated with the disease X-linked intellectual disability-ataxia-apraxia syndrome (ORPHA:85338).